- Cone dystrophy (HP:0008020, a Human Phenotype Ontology term): Inherited progressive cone degeneration. Evidence: IEA. (OMIM:300155)
- X-linked inheritance (HP:0001417, a Human Phenotype Ontology term): A mode of inheritance that is observed for traits related to a gene encoded on the X chromosome. Evidence: IEA. (OMIM:300155)
- Rod-cone dystrophy (HP:0000510, a Human Phenotype Ontology term): An inherited retinal disease subtype in which the rod photoreceptors appear to be more severely affected than the cone photoreceptors. Typical presentation is with nyctalopia (due to rod dysfunction) followed by loss of mid-peripheral field of vision, which gradually extends and leaves many patients with a small central island of vision due to the preservation of macular cones. Evidence: IEA. Onset: Juvenile onset (HP:0003621, a Human Phenotype Ontology term). (OMIM:300155)
These phenotypes are associated with the disease retinitis pigmentosa 24 (OMIM:300155, an entry in Online Mendelian Inheritance in Man).